- Skeletal muscle atrophy (HP:0003202): The presence of skeletal muscular atrophy (which is also known as amyotrophy). Evidence: PCS. Frequency: 3/5. (PMID:29449188)
- Broad-based gait (HP:0002136): An abnormal gait pattern in which persons stand and walk with their feet spaced widely apart. This is often a component of cerebellar ataxia. Evidence: TAS. (OMIM:601238)
- Congenital onset (HP:0003577): A phenotypic abnormality that is present at birth. Evidence: PCS. (PMID:14556008)
- Truncal ataxia (HP:0002078): Truncal ataxia is a sign of ataxia characterized by instability of the trunk. It usually occurs during sitting. Evidence: PCS. (PMID:14556008)
- Bradykinesia (HP:0002067): Bradykinesia literally means slow movement, and is used clinically to denote a slowness in the execution of movement (in contrast to hypokinesia, which is used to refer to slowness in the initiation of movement). Evidence: PCS. Frequency: 3/5. (PMID:29449188)
- Strabismus (HP:0000486): A misalignment of the eyes so that the visual axes deviate from bifoveal fixation. The classification of strabismus may be based on a number of features including the relative position of the eyes, whether the deviation is latent or manifest, intermittent or constant, concomitant or otherwise and according to the age of onset and the relevance of any associated refractive error. Evidence: PCS. Frequency: 4/5. (PMID:29449188)
- Cerebellar hypoplasia (HP:0001321): Cerebellar hypoplasia is a descriptive term implying a cerebellum with a reduced volume, but a normal shape and is stable over time. Evidence: PCS. (PMID:14556008)
- Dystonia (HP:0001332): An abnormally increased muscular tone that causes fixed abnormal postures. There is a slow, intermittent twisting motion that leads to exaggerated turning and posture of the extremities and trunk. Evidence: PCS. Frequency: 2/5. (PMID:29449188)
- Cerebellar atrophy (HP:0001272): Cerebellar atrophy is defined as a cerebellum with initially normal structures, in a posterior fossa with normal size, which displays enlarged fissures (interfolial spaces) in comparison to the foliae secondary to loss of tissue. Cerebellar atrophy implies irreversible loss of tissue and result from an ongoing progressive disease until a final stage is reached or a single injury, e.g. an intoxication or infectious event. Evidence: PCS. Frequency: 5/5. (PMID:29449188)
- Dysarthria (HP:0001260): Dysarthric speech is a general description referring to a neurological speech disorder characterized by poor articulation. Depending on the involved neurological structures, dysarthria may be further classified as spastic, flaccid, ataxic, hyperkinetic and hypokinetic, or mixed. Evidence: PCS. (PMID:14556008)
- Gait ataxia (HP:0002066): A type of ataxia characterized by the impairment of the ability to coordinate the movements required for normal walking. Gait ataxia is characteirzed by a wide-based staggering gait with a tendency to fall. Evidence: PCS. Frequency: 15/15. (PMID:14556008;PMID:29449188)
- Hypotonia (HP:0001252): Hypotonia is an abnormally low muscle tone (the amount of tension or resistance to movement in a muscle). Even when relaxed, muscles have a continuous and passive partial contraction which provides some resistance to passive stretching. Hypotonia thus manifests as diminished resistance to passive stretching. Hypotonia is not the same as muscle weakness, although the two conditions can co-exist. Evidence: PCS. Onset: Congenital onset (HP:0003577). (PMID:14556008)
- Global developmental delay (HP:0001263): A delay in the achievement of motor or mental milestones in the domains of development of a child, including motor skills, speech and language, cognitive skills, and social and emotional skills. This term should only be used to describe children younger than five years of age. Evidence: PCS. (PMID:14556008)
- Ataxia (HP:0001251): Ataxia refers to impaired coordination of voluntary muscle movement. Cerebellar ataxia refers to ataxia due to dysfunction of the cerebellum. This causes a variety of elementary neurological deficits including asynergy (lack of coordination between muscles, limbs and joints), dysmetria (lack of ability to judge distances that can lead to under- or overshoot in grasping movements), and dysdiadochokinesia (inability to perform rapid movements requiring antagonizing muscle groups to be switched on and off repeatedly). Evidence: PCS. Frequency: 5/5. (PMID:29449188)
- Infantile onset (HP:0003593): Onset of signs or symptoms of disease between 28 days to one year of life. Evidence: PCS. Frequency: 5/5. (PMID:29449188)
- Intention tremor (HP:0002080): A type of kinetic tremor that occurs during target directed movement is called intention tremor. That is, an oscillatory cerebellar ataxia that tends to be absent when the limbs are inactive and during the first part of voluntary movement but worsening as the movement continues and greater precision is required (e.g., in touching a target such as the patient's nose or a physician's finger). Evidence: PCS. (PMID:14556008)
- Nystagmus (HP:0000639): Rhythmic, involuntary oscillations of one or both eyes related to abnormality in fixation, conjugate gaze, or vestibular mechanisms. Evidence: PCS. (PMID:14556008)
- Hypomimic face (HP:0000338): A reduced degree of motion of the muscles beneath the skin of the face, often associated with reduced facial crease formation. Evidence: PCS. Frequency: 5/5. (PMID:29449188)
- Autosomal recessive inheritance (HP:0000007): A mode of inheritance that is observed for traits related to a gene encoded on one of the autosomes (i.e., the human chromosomes 1-22) in which a trait manifests in individuals with two pathogenic alleles, either homozygotes (two copies of the same mutant allele) or compound heterozygotes (whereby each copy of a gene has a distinct mutant allele). Evidence: PCS. (PMID:14556008)
- Pes planus (HP:0001763): A foot where the longitudinal arch of the foot is in contact with the ground or floor when the individual is standing; or, in a patient lying supine, a foot where the arch is in contact with the surface of a flat board pressed against the sole of the foot by the examiner with a pressure similar to that expected from weight bearing; or, the height of the arch is reduced. Evidence: PCS. Frequency: 5/5. (PMID:29449188)
- Abnormal retinal morphology (HP:0000479): A structural abnormality of the retina. Evidence: PCS. Frequency: 0/5. (PMID:29449188)
These phenotypes are associated with the disease Cayman type cerebellar ataxia (OMIM:601238).